- Heinz bodies (HP:0020082): A type of erythrocyte inclusion composed of denatured hemoglobin. Evidence: IEA. (OMIM:614164)
- Compensated hemolytic anemia (HP:0004863). Evidence: TAS. (OMIM:614164)
- Neonatal hyperbilirubinemia (HP:0003265): A type of hyperbilirubinemia with neonatal onset. Evidence: TAS. (OMIM:614164)
- Autosomal recessive inheritance (HP:0000007): A mode of inheritance that is observed for traits related to a gene encoded on one of the autosomes (i.e., the human chromosomes 1-22) in which a trait manifests in individuals with two pathogenic alleles, either homozygotes (two copies of the same mutant allele) or compound heterozygotes (whereby each copy of a gene has a distinct mutant allele). Evidence: TAS. (OMIM:614164)
These phenotypes are associated with the disease gluthathione peroxidase deficiency (OMIM:614164).